- Nephrocalcinosis (HP:0000121): Nephrocalcinosis is the deposition of calcium salts in renal parenchyma. Evidence: PCS. Frequency: 4/5. (PMID:8640224)
- Hyposthenuria (HP:0003158): An abnormally low urinary specific gravity, i.e., reduced concentration of solutes in the urine. Evidence: IEA. (OMIM:601678)
- Short stature (HP:0004322): A height below that which is expected according to age and gender norms. Although there is no universally accepted definition of short stature, many refer to "short stature" as height more than 2 standard deviations below the mean for age and gender (or below the 3rd percentile for age and gender dependent norms). Evidence: IEA. (OMIM:601678)
- Hypochloremia (HP:0003113): The concentration of chloride in the blood circulation is below the lower limit of normal. Evidence: IEA. (OMIM:601678)
- Seizure (HP:0001250): A seizure is an intermittent abnormality of nervous system physiology characterized by a transient occurrence of signs and/or symptoms due to abnormal excessive or synchronous neuronal activity in the brain. Evidence: IEA. (OMIM:601678)
- Muscle spasm (HP:0003394): Sudden and involuntary contractions of one or more muscles. Evidence: IEA. (OMIM:601678)
- Hypercalcemia (HP:0003072): The concentration of calcium in the blood circulation is above the upper limit of normal. Evidence: TAS. (OMIM:601678)
- Hypomagnesemia (HP:0002917): The concentration of magnesium in the blood circulation is below the lower limit of normal. Evidence: PCS. Frequency: 0/5. (PMID:8640224)
- Increased circulating aldosterone concentration (HP:0000859): Overproduction of the mineralocorticoid aldosterone by the adrenal cortex. Evidence: PCS. Frequency: 5/5. (PMID:8640224)
- Failure to thrive (HP:0001508): Failure to thrive (FTT) refers to a child whose physical growth is substantially below the norm. Evidence: IEA. (OMIM:601678)
- Osteopenia (HP:0000938): Osteopenia is a term to define bone density that is not normal but also not as low as osteoporosis. By definition from the World Health Organization osteopenia is defined by bone densitometry as a T score -1 to -2.5. Evidence: IEA. (OMIM:601678)
- Fetal onset (HP:0011461): Onset prior to birth but after 8 weeks of embryonic development (corresponding to a gestational age of 10 weeks). Evidence: PCS. Frequency: 5/5. (PMID:8640224)
- Dehydration (HP:0001944). Evidence: PCS. Frequency: 5/5. Onset: Neonatal onset (HP:0003623). (PMID:8640224)
- Hyperchloriduria (HP:0002914): An increased concentration of chloride in the urine. Evidence: IEA. (OMIM:601678)
- Hyperprostaglandinuria (HP:0003527): An increased concentration of prostaglandin in the urine. Evidence: IEA. (OMIM:601678)
- Chondrocalcinosis (HP:0000934): Radiographic evidence of articular calcification that represent calcium pyrophosphate depositions in soft tissue surrounding joints and at the insertions of tendons near joints (Entheses/Sharpey fibers) . Evidence: IEA. (OMIM:601678)
- Fever (HP:0001945): Body temperature elevated above the normal range. Evidence: IEA. (OMIM:601678)
- Constipation (HP:0002019): Infrequent or difficult evacuation of feces. Evidence: IEA. (OMIM:601678)
- Low-to-normal blood pressure (HP:0002632). Evidence: IEA. (OMIM:601678)
- Intellectual disability (HP:0001249): The term intellectual disability or intellectual developmental disorder is used to describe significantly sub-average intellectual and adaptive functioning based on clinical assessment and as measured by individually administered, appropriately normed, standardized and validated tests of intellectual functioning and adaptive behavior, with onset during the developmental period from infancy through adolescence. Evidence: IEA. (OMIM:601678)
- Premature birth (HP:0001622): The birth of a baby of less than 37 weeks of gestational age. Evidence: PCS. Frequency: 5/5. (PMID:8640224)
- Diarrhea (HP:0002014): Abnormally increased frequency (usually defined as three or more) loose or watery bowel movements a day. Evidence: IEA. (OMIM:601678)
- Polyhydramnios (HP:0001561): The presence of excess amniotic fluid in the uterus during pregnancy. Evidence: PCS. Frequency: 5/5. (PMID:8640224)
- Paresthesia (HP:0003401): Abnormal sensations such as tingling, pricking, or numbness of the skin with no apparent physical cause. Evidence: IEA. (OMIM:601678)
- Increased serum prostaglandin E2 (HP:0003566): An increased concentration of prostaglandin E2 in the blood. Evidence: IEA. (OMIM:601678)
- Generalized muscle weakness (HP:0003324): Generalized weakness or decreased strength of the muscles, affecting both distal and proximal musculature. Evidence: IEA. (OMIM:601678)
- Hypokalemic metabolic alkalosis (HP:0001960). Evidence: IEA. (OMIM:601678)
- Vomiting (HP:0002013): Forceful ejection of the contents of the stomach through the mouth by means of a series of involuntary spasmic contractions. Evidence: IEA. (OMIM:601678)
- Renal juxtaglomerular cell hypertrophy/hyperplasia (HP:0000111): Increased number and size of the juxtaglomerular cells. Evidence: IEA. (OMIM:601678)
- Fetal polyuria (HP:0001563): Abnormally increased production of urine by the fetus resulting in polyhydramnios. Evidence: IEA. (OMIM:601678)
- Global developmental delay (HP:0001263): A delay in the achievement of motor or mental milestones in the domains of development of a child, including motor skills, speech and language, cognitive skills, and social and emotional skills. This term should only be used to describe children younger than five years of age. Evidence: IEA. (OMIM:601678)
- Hypercalciuria (HP:0002150). Evidence: PCS. Frequency: 5/5. (PMID:8640224)
- Tetany (HP:0001281): A condition characterized by intermittent involuntary contraction of muscles (spasms) related to hypocalcemia or occasionally magnesium deficiency. Evidence: IEA. (OMIM:601678)
- Increased urinary potassium (HP:0003081): An increased concentration of potassium(1+) in the urine. Evidence: IEA. (OMIM:601678)
- Increased circulating renin concentration (HP:0000848): An increased level of renin in the blood. Evidence: IEA. (OMIM:601678)
- Small for gestational age (HP:0001518): Smaller than normal size according to sex and gestational age related norms, defined as a weight below the 10th percentile for the gestational age. Evidence: PCS. Frequency: 5/5. (PMID:8640224)
- Renal potassium wasting (HP:0000128): High urine potassium in the presence of hypokalemia. Evidence: IEA. (OMIM:601678)
- Hyperparathyroidism (HP:0000843): Excessive production of parathyroid hormone (PTH) by the parathyroid glands. Evidence: TAS. Frequency: Occasional (HP:0040283). (OMIM:601678)
- Autosomal recessive inheritance (HP:0000007): A mode of inheritance that is observed for traits related to a gene encoded on one of the autosomes (i.e., the human chromosomes 1-22) in which a trait manifests in individuals with two pathogenic alleles, either homozygotes (two copies of the same mutant allele) or compound heterozygotes (whereby each copy of a gene has a distinct mutant allele). Evidence: IEA. (OMIM:601678)
- Hypokalemia (HP:0002900): The concentration of potassium(1+) in the blood circulation is below the lower limit of normal. Evidence: PCS. Frequency: 5/5. (PMID:8640224)
- Polyuria (HP:0000103): An increased rate of urine production. Evidence: IEA. (OMIM:601678)
- Renal salt wasting (HP:0000127): A high concentration of one or more electrolytes in the urine in the presence of low serum concentrations of the electrolyte(s). Evidence: TAS. (OMIM:601678)
- Hyperactive renin-angiotensin system (HP:0000841): An abnormally increased activity of the renin-angiotensin system, causing hypertension by a combination of volume excess and vasoconstrictor mechanisms. Evidence: PCS. Frequency: 5/5. (PMID:8640224)
These phenotypes are associated with the disease Bartter disease type 1 (OMIM:601678).